- Strabismus (HP:0000486): A misalignment of the eyes so that the visual axes deviate from bifoveal fixation. The classification of strabismus may be based on a number of features including the relative position of the eyes, whether the deviation is latent or manifest, intermittent or constant, concomitant or otherwise and according to the age of onset and the relevance of any associated refractive error. Evidence: TAS. Frequency: Very frequent (HP:0040281). (ORPHA:1369)
- Glaucoma (HP:0000501): Glaucoma refers loss of retinal ganglion cells in a characteristic pattern of optic neuropathy usually associated with increased intraocular pressure. Evidence: TAS. Frequency: Occasional (HP:0040283). (ORPHA:1369)
- Abnormal electroretinogram (HP:0000512): Any abnormality of the electrical responses of various cell types in the retina as measured by electroretinography. Evidence: TAS. Frequency: Occasional (HP:0040283). (ORPHA:1369)
- Cataract (HP:0000518): A cataract is an opacity or clouding that develops in the crystalline lens of the eye or in its capsule. Evidence: TAS. Frequency: Very frequent (HP:0040281). (ORPHA:1369)
- Myopia (HP:0000545): An abnormality of refraction characterized by the ability to see objects nearby clearly, while objects in the distance appear blurry. Evidence: TAS. Frequency: Frequent (HP:0040282). (ORPHA:1369)
- Nystagmus (HP:0000639): Rhythmic, involuntary oscillations of one or both eyes related to abnormality in fixation, conjugate gaze, or vestibular mechanisms. Evidence: TAS. Frequency: Very frequent (HP:0040281). (ORPHA:1369)
- Corneal dystrophy (HP:0001131): The term corneal dystrophy embraces a heterogenous group of bilateral genetically determined non-inflammatory corneal diseases that are restricted to the cornea. Evidence: TAS. Frequency: Occasional (HP:0040283). (ORPHA:1369)
- Hypertrophic cardiomyopathy (HP:0001639): Hypertrophic cardiomyopathy (HCM) is defined by the presence of increased ventricular wall thickness or mass in the absence of loading conditions (hypertension, valve disease) sufficient to cause the observed abnormality. Evidence: TAS. Frequency: Very frequent (HP:0040281). (ORPHA:1369)
- Lactic acidosis (HP:0003128): An abnormal buildup of lactic acid in the body, leading to acidification of the blood and other bodily fluids. Evidence: TAS. Frequency: Very frequent (HP:0040281). (ORPHA:1369)
- Myopathy (HP:0003198): A disorder of muscle unrelated to impairment of innervation or neuromuscular junction. Evidence: TAS. Frequency: Very frequent (HP:0040281). (ORPHA:1369)
These phenotypes are associated with the disease Congenital cataract-hypertrophic cardiomyopathy-mitochondrial myopathy syndrome (ORPHA:1369).